- Abnormality of the ankle (HP:0003028, a Human Phenotype Ontology term): An anomaly of the joint that connects the foot with the leg. Evidence: TAS. Frequency: Very frequent (HP:0040281, a Human Phenotype Ontology term). (ORPHA:1412)
- Short stature (HP:0004322, a Human Phenotype Ontology term): A height below that which is expected according to age and gender norms. Although there is no universally accepted definition of short stature, many refer to "short stature" as height more than 2 standard deviations below the mean for age and gender (or below the 3rd percentile for age and gender dependent norms). Evidence: TAS. Frequency: Very frequent (HP:0040281, a Human Phenotype Ontology term). (ORPHA:1412)
- Tarsal synostosis (HP:0008368, a Human Phenotype Ontology term): Synostosis (bony fusion) involving one or more bones of the tarsus (calcaneus, talus, cuboid, navicular, cuneiiform bones). Evidence: TAS. Frequency: Very frequent (HP:0040281, a Human Phenotype Ontology term). (ORPHA:1412)
These phenotypes are associated with the disease Tarsal-carpal coalition syndrome (ORPHA:1412, an Orphanet rare-disease identifier).